- Cutaneous photosensitivity (HP:0000992): An increased sensitivity of the skin to light. Photosensitivity may result in a rash upon exposure to the sun (which is known as photodermatosis). Photosensitivity can be diagnosed by phototests in which light is shone on small areas of skin. Evidence: TAS. Frequency: Frequent (HP:0040282). (ORPHA:97352)
- Vomiting (HP:0002013): Forceful ejection of the contents of the stomach through the mouth by means of a series of involuntary spasmic contractions. Evidence: TAS. Frequency: Frequent (HP:0040282). (ORPHA:97352)
- Dysphagia (HP:0002015): Difficulty in swallowing. Evidence: TAS. Frequency: Frequent (HP:0040282). (ORPHA:97352)
- Nausea (HP:0002018): A sensation of unease in the stomach together with an urge to vomit. Evidence: TAS. Frequency: Frequent (HP:0040282). (ORPHA:97352)
- Malabsorption (HP:0002024): Impaired ability to absorb one or more nutrients from the intestine. Evidence: TAS. Frequency: Frequent (HP:0040282). (ORPHA:97352)
- Headache (HP:0002315): Cephalgia, or pain sensed in various parts of the head, not confined to the area of distribution of any nerve. Evidence: TAS. Frequency: Frequent (HP:0040282). (ORPHA:97352)
- Cachexia (HP:0004326): Severe weight loss, wasting of muscle, loss of appetite, and general debility related to a chronic disease. Evidence: TAS. Frequency: Frequent (HP:0040282). (ORPHA:97352)
- Malnutrition (HP:0004395): A deficiency in the intake of energy and nutrients. Evidence: TAS. Frequency: Frequent (HP:0040282). (ORPHA:97352)
- Poor appetite (HP:0004396): A reduced desire to eat. Evidence: TAS. Frequency: Frequent (HP:0040282). (ORPHA:97352)
- Gastritis (HP:0005263): The presence of inflammation of the gastric mucous membrane. Evidence: TAS. Frequency: Frequent (HP:0040282). (ORPHA:97352)
- Irregular hyperpigmentation (HP:0007400). Evidence: TAS. Frequency: Frequent (HP:0040282). (ORPHA:97352)
- Abnormal blistering of the skin (HP:0008066): The presence of one or more bullae on the skin, defined as fluid-filled blisters more than 5 mm in diameter with thin walls. Evidence: TAS. Frequency: Frequent (HP:0040282). (ORPHA:97352)
- Stomatitis (HP:0010280): Stomatitis is an inflammation of the mucous membranes of any of the structures in the mouth. Evidence: TAS. Frequency: Frequent (HP:0040282). (ORPHA:97352)
- Fatigue (HP:0012378): A subjective feeling of tiredness characterized by a lack of energy and motivation. Evidence: TAS. Frequency: Frequent (HP:0040282). (ORPHA:97352)
- Pain (HP:0012531): An unpleasant sensory and emotional experience associated with actual or potential tissue damage, or described in terms of such damage. Evidence: TAS. Frequency: Frequent (HP:0040282). (ORPHA:97352)
- Delirium (HP:0031258): A state of sudden and severe confusion. Evidence: TAS. Frequency: Frequent (HP:0040282). (ORPHA:97352)
- Cognitive impairment (HP:0100543): Abnormal cognition is characterized by deficits in thinking, reasoning, or remembering. Evidence: TAS. Frequency: Frequent (HP:0040282). (ORPHA:97352)
- Schizophrenia (HP:0100753): A mental disorder characterized by a disintegration of thought processes and emotional responsiveness. It most commonly manifests as auditory hallucinations, paranoid or bizarre delusions, or disorganized speech and thinking. It is accompanied by significant social or occupational dysfunction. The onset of symptoms typically occurs in young adulthood, with a global lifetime prevalence of about 1%. This term is not a helpful parent term to describe abnormal experiences. Evidence: TAS. Frequency: Frequent (HP:0040282). (ORPHA:97352)
- Cheilitis (HP:0100825): Inflammation of the lip. Evidence: TAS. Frequency: Frequent (HP:0040282). (ORPHA:97352)
- Decreased circulating vitamin B3 concentration (HP:0100497): The concentration of vitamin B3 in the blood circulation is below the lower limit of normal. Evidence: TAS. Frequency: Very frequent (HP:0040281). (ORPHA:97352)
- Macroglossia (HP:0000158): Increased length and width of the tongue. Evidence: TAS. Frequency: Frequent (HP:0040282). (ORPHA:97352)
- Glossitis (HP:0000206): Inflammation of the tongue. Evidence: TAS. Frequency: Frequent (HP:0040282). (ORPHA:97352)
- Depression (HP:0000716): Frequently experiencing feelings of being down, miserable, and/or hopeless; struggling to recover from these moods; having a pessimistic outlook on the future; feeling a pervasive sense of shame; having a low self-worth; experiencing thoughts of suicide and engaging in suicidal behavior. Evidence: TAS. Frequency: Frequent (HP:0040282). (ORPHA:97352)
- Dementia (HP:0000726): A loss of global cognitive ability of sufficient amount to interfere with normal social or occupational function. Dementia represents a loss of previously present cognitive abilities, generally in adults, and can affect memory, thinking, language, judgment, and behavior. Evidence: TAS. Frequency: Frequent (HP:0040282). (ORPHA:97352)
- Hallucinations (HP:0000738): Perceptions in a conscious and awake state that, in the absence of external stimuli, have qualities of real perception. These perceptions are vivid, substantial, and located in external objective space. Evidence: TAS. Frequency: Frequent (HP:0040282). (ORPHA:97352)
- Dry skin (HP:0000958): Skin characterized by the lack of natural or normal moisture. Evidence: TAS. Frequency: Frequent (HP:0040282). (ORPHA:97352)
- Hyperkeratosis (HP:0000962): Hyperkeratosis is a histopathological term defining a thickened stratum corneum and may be present in many different skin conditions, with many possible overlaps. Hyperkeratosis refers to the increased thickness of the stratum corneum, the outer layer of the skin. Hyperkeratosis is subclassified as orthokeratotic or parakeratotic. Orthokeratotic hyperkeratosis refers to the thickening of the keratin layer with preserved keratinocyte maturation, while parakeratotic hyperkeratosis shows retained nuclei as a sign of delayed maturation of keratinocytes. Evidence: TAS. Frequency: Frequent (HP:0040282). (ORPHA:97352)
- Skin rash (HP:0000988): A red eruption of the skin. Evidence: TAS. Frequency: Frequent (HP:0040282). (ORPHA:97352)
- Photophobia (HP:0000613): Excessive sensitivity to light with the sensation of discomfort or pain in the eyes due to exposure to bright light. Evidence: TAS. Frequency: Occasional (HP:0040283). (ORPHA:97352)
- Emotional lability (HP:0000712): Unstable emotional experiences and frequent mood changes; emotions that are easily aroused, intense, and/or disproportionate to events and circumstances. Evidence: TAS. Frequency: Occasional (HP:0040283). (ORPHA:97352)
- Anxiety (HP:0000739): Intense feelings of nervousness, tension, or panic often arise in response to interpersonal stresses. There is worry about the negative effects of past unpleasant experiences and future negative possibilities. Individuals may feel fearful, apprehensive, or threatened by uncertainty, and they may also have fears of falling apart or losing control. Evidence: TAS. Frequency: Occasional (HP:0040283). (ORPHA:97352)
- Muscle weakness (HP:0001324): Reduced strength of muscles. Evidence: TAS. Frequency: Occasional (HP:0040283). (ORPHA:97352)
- Diarrhea (HP:0002014): Abnormally increased frequency (usually defined as three or more) loose or watery bowel movements a day. Evidence: TAS. Frequency: Occasional (HP:0040283). (ORPHA:97352)
- Constipation (HP:0002019): Infrequent or difficult evacuation of feces. Evidence: TAS. Frequency: Occasional (HP:0040283). (ORPHA:97352)
- Sleep disturbance (HP:0002360): An abnormal pattern in the quality, quantity, or characteristics of sleep. Evidence: TAS. Frequency: Occasional (HP:0040283). (ORPHA:97352)
- Paresthesia (HP:0003401): Abnormal sensations such as tingling, pricking, or numbness of the skin with no apparent physical cause. Evidence: TAS. Frequency: Occasional (HP:0040283). (ORPHA:97352)
- Sensorimotor neuropathy (HP:0007141). Evidence: TAS. Frequency: Occasional (HP:0040283). (ORPHA:97352)
- Malar rash (HP:0025300): An erythematous (red), flat facial rash that affects the skin in the malar area (over the cheekbones) and extends over the bridge of the nose. Evidence: TAS. Frequency: Occasional (HP:0040283). (ORPHA:97352)
- Diminished ability to concentrate (HP:0031987): The inability to focus or concentrate on a specific task, activity, or object. The subject may find themselves unable to grasp or understand written text and re-reads frequently without understanding. Familiar tasks or activities are severely compromised due to the lack of ability to concentrate. Thinking through multi-step problems is typically very difficult or impossible, leading to avoidance of such activities. Evidence: TAS. Frequency: Occasional (HP:0040283). (ORPHA:97352)
- Achlorhydria (HP:0032448): A condition in which production of hydrochloric acid in the stomach is absent. Evidence: TAS. Frequency: Occasional (HP:0040283). (ORPHA:97352)
- Livedo reticularis (HP:0033505): Livedo reticularis is characterized by the presence of a bluish purple, mottled or netlike pattern in unbroken circles on the skin. Exposure to cold environments usually intensifies the vascular pattern. Presumably, the condition results from slow or stagnant blood flow, vessel-wall pathology, and decreased oxygen tension. Evidence: TAS. Frequency: Occasional (HP:0040283). (ORPHA:97352)
- Optic neuritis (HP:0100653): Inflammation of the optic nerve. Evidence: TAS. Frequency: Occasional (HP:0040283). (ORPHA:97352)
- Skin vesicle (HP:0200037): A circumscribed, fluid-containing, epidermal elevation less than 10mm in diameter at the widest point that (i) Contain serous exudates or serum mixed with blood or pus; (ii) Are discrete, grouped, irregularly distributed, or linear as in Rhus dermatitis; (iii) Are short-lived. Vesicles may break spontaneously or evolve into bullae by enlarging or coalescing with other vesicles. Evidence: TAS. Frequency: Occasional (HP:0040283). (ORPHA:97352)
These phenotypes are associated with the disease Pellagra (ORPHA:97352).